- Hearing impairment (HP:0000365): A decreased magnitude of the sensory perception of sound. Evidence: TAS. (OMIM:118420)
- Vertigo (HP:0002321): An abnormal sensation of spinning while the body is actually stationary. Evidence: IEA. (OMIM:118420)
- Syringomyelia (HP:0003396): Dilated, glial-lined cavity in spinal cord. This cavity does not communicate with the central canal, and usually is between the dorsal columns unilaterally or bilaterally along the side of the cord. Evidence: TAS. (OMIM:118420)
- Gait ataxia (HP:0002066): A type of ataxia characterized by the impairment of the ability to coordinate the movements required for normal walking. Gait ataxia is characteirzed by a wide-based staggering gait with a tendency to fall. Evidence: IEA. (OMIM:118420)
- Urinary incontinence (HP:0000020): Loss of the ability to control the urinary bladder leading to involuntary urination. Evidence: IEA. (OMIM:118420)
- Tinnitus (HP:0000360): Tinnitus is an auditory perception that can be described as the experience of sound, in the ear or in the head, in the absence of external acoustic stimulation. Evidence: IEA. (OMIM:118420)
- Lower limb spasticity (HP:0002061): Spasticity (velocity-dependent increase in tonic stretch reflexes with increased muscle tone and hyperexcitable tendon reflexes) in the muscles of the lower limbs, hips, and pelvis. Evidence: TAS. (OMIM:118420)
- Limb muscle weakness (HP:0003690): Reduced strength and weakness of the muscles of the arms and legs. Evidence: IEA. (OMIM:118420)
- Neck pain (HP:0030833): An unpleasant sensation characterized by physical discomfort (such as pricking, throbbing, or aching) localized to the neck. Evidence: TAS. (OMIM:118420)
- Nystagmus (HP:0000639): Rhythmic, involuntary oscillations of one or both eyes related to abnormality in fixation, conjugate gaze, or vestibular mechanisms. Evidence: IEA. (OMIM:118420)
- Photophobia (HP:0000613): Excessive sensitivity to light with the sensation of discomfort or pain in the eyes due to exposure to bright light. Evidence: IEA. (OMIM:118420)
- Unsteady gait (HP:0002317). Evidence: IEA. (OMIM:118420)
- Headache (HP:0002315): Cephalgia, or pain sensed in various parts of the head, not confined to the area of distribution of any nerve. Evidence: TAS. (OMIM:118420)
- Dysphagia (HP:0002015): Difficulty in swallowing. Evidence: IEA. (OMIM:118420)
- Paresthesia (HP:0003401): Abnormal sensations such as tingling, pricking, or numbness of the skin with no apparent physical cause. Evidence: IEA. (OMIM:118420)
- Diplopia (HP:0000651): Diplopia is a condition in which a single object is perceived as two images, it is also known as double vision. Evidence: IEA. (OMIM:118420)
- Scoliosis (HP:0002650): The presence of an abnormal lateral curvature of the spine. Evidence: IEA. (OMIM:118420)
- Babinski sign (HP:0003487): Upturning of the big toe (and sometimes fanning of the other toes) in response to stimulation of the sole of the foot. If the Babinski sign is present it can indicate damage to the corticospinal tract. Evidence: IEA. (OMIM:118420)
- Lower limb hyperreflexia (HP:0002395): Increased intensity of the a reflex in the leg. Evidence: TAS. (OMIM:118420)
- Dysarthria (HP:0001260): Dysarthric speech is a general description referring to a neurological speech disorder characterized by poor articulation. Depending on the involved neurological structures, dysarthria may be further classified as spastic, flaccid, ataxic, hyperkinetic and hypokinetic, or mixed. Evidence: IEA. (OMIM:118420)
- Areflexia of upper limbs (HP:0012046): Inability to elicit tendon reflexes in the upper limbs. Evidence: TAS. (OMIM:118420)
- Chiari type I malformation (HP:0007099): Arnold-Chiari type I malformation refers to a relatively mild degree of herniation of the posteroinferior region of the cerebellum (the cerebellar tonsils) into the cervical canal with little or no displacement of the fourth ventricle. It is characterized by one or both pointed (not rounded) cerebellar tonsils that project 5 mm below the foramen magnum, measured by a line drawn from the basion to the opisthion (McRae Line). Evidence: TAS. (OMIM:118420)
- Hyperacusis (HP:0010780): Over-sensitivity to certain frequency ranges of sound. Evidence: IEA. (OMIM:118420)
- Small flat posterior fossa (HP:0005759): An abnormally small and flat configuration of the posterior cranial fossa. Evidence: IEA. (OMIM:118420)
- Basilar impression (HP:0005758): Abnormal elevation of the floor of the posterior fossa including occipital condyles and foramen magnum. Evidence: TAS. (OMIM:118420)
- Autosomal dominant inheritance (HP:0000006): A mode of inheritance that is observed for traits related to a gene encoded on one of the autosomes (i.e., the human chromosomes 1-22) in which a trait manifests in heterozygotes. In the context of medical genetics, an autosomal dominant disorder is caused when a single copy of the mutant allele is present. Males and females are affected equally, and can both transmit the disorder with a risk of 50% for each child of inheriting the mutant allele. Evidence: IEA. (OMIM:118420)
These phenotypes are associated with the disease Chiari malformation type I (OMIM:118420).